Phenotypes associated with the disease nasopharyngeal carcinoma, susceptibility to, 1 (OMIM:607107):
- Polygenic inheritance (HP:0010982): A mode of inheritance that depends on a mixture of major and minor genetic determinants possibly together with environmental factors. Diseases inherited in this manner are termed complex diseases. Evidence: TAS. (OMIM:607107)
- Neoplasia of the nasopharynx (HP:0100630). Evidence: TAS. (OMIM:607107)